- Angioedema (HP:0100665): Rapid swelling (edema) of the dermis, subcutaneous tissue, mucosa and submucosal tissues of the skin of the face, normally around the mouth, and the mucosa of the mouth and/or throat, as well as the tongue during a period of minutes to several hours. The swelling can also occur elsewhere, typically in the hands. Angioedema is similar to urticaria, but the swelling is subcutaneous rather than on the epidermis. Evidence: IEA. (PMID:28795768)
- Facial edema (HP:0000282). Evidence: PCS. (PMID:28795768)
- Young adult onset (HP:0011462): Onset of disease at the age of between 16 and 40 years. Evidence: PCS. (PMID:28795768)
- Swollen lip (HP:0031244): Enlargement of the lip typically due to fluid buildup or inflammation. Evidence: PCS. (PMID:28795768)
- Laryngeal edema (HP:0012027): An abnormal accumulation of fluid and swelling in the tissues of the larynx. Evidence: PCS. (PMID:28795768)
- Autosomal dominant inheritance (HP:0000006): A mode of inheritance that is observed for traits related to a gene encoded on one of the autosomes (i.e., the human chromosomes 1-22) in which a trait manifests in heterozygotes. In the context of medical genetics, an autosomal dominant disorder is caused when a single copy of the mutant allele is present. Males and females are affected equally, and can both transmit the disorder with a risk of 50% for each child of inheriting the mutant allele. Evidence: PCS. (PMID:28795768)
These phenotypes are associated with the disease angioedema, hereditary, 4 (OMIM:619360).